- Autoimmunity (HP:0002960): The occurrence of an immune reaction against the organism's own cells or tissues. Evidence: TAS. Frequency: Very frequent (HP:0040281). (ORPHA:79481)
- Acantholysis (HP:0100792): The loss of intercellular connections, such as desmosomes, resulting in loss of cohesion between keratinocytes. Evidence: TAS. Frequency: Very frequent (HP:0040281). (ORPHA:79481)
- Pruritus (HP:0000989): Pruritus is an itch or a sensation that makes a person want to scratch. This term refers to an abnormally increased disposition to experience pruritus. Evidence: TAS. Frequency: Frequent (HP:0040282). (ORPHA:79481)
- Abnormal scalp morphology (HP:0001965): Any anomaly of the scalp, the skin an subcutaneous tissue of the head on which head hair grows. Evidence: TAS. Frequency: Frequent (HP:0040282). (ORPHA:79481)
- Crusting erythematous dermatitis (HP:0007473). Evidence: TAS. Frequency: Frequent (HP:0040282). (ORPHA:79481)
- Abnormal blistering of the skin (HP:0008066): The presence of one or more bullae on the skin, defined as fluid-filled blisters more than 5 mm in diameter with thin walls. Evidence: TAS. Frequency: Frequent (HP:0040282). (ORPHA:79481)
- Erythema (HP:0010783): Redness of the skin, caused by hyperemia of the capillaries in the lower layers of the skin. Evidence: TAS. Frequency: Frequent (HP:0040282). (ORPHA:79481)
- Erythematous plaque (HP:0025474): A plaque (a solid, raised, plateau-like (flat-topped) lesion greater than 1 cm in diameter) with a red or reddish color often associated with inflammation or irritation. Evidence: TAS. Frequency: Frequent (HP:0040282). (ORPHA:79481)
- Scaling skin (HP:0040189): Refers to the loss of the outer layer of the epidermis in large, scale-like flakes. Evidence: TAS. Frequency: Frequent (HP:0040282). (ORPHA:79481)
- Skin erosion (HP:0200041): A discontinuity of the skin exhibiting incomplete loss of the epidermis, a lesion that is moist, circumscribed, and usually depressed. Evidence: TAS. Frequency: Frequent (HP:0040282). (ORPHA:79481)
- Oral ulcer (HP:0000155): Erosion of the mucous mebrane of the mouth with local excavation of the surface, resulting from the sloughing of inflammatory necrotic tissue. Evidence: TAS. Frequency: Occasional (HP:0040283). (ORPHA:79481)
- Erythroderma (HP:0001019): An inflammatory exfoliative dermatosis involving nearly all of the surface of the skin. Erythroderma develops suddenly. A patchy erythema may generalize and spread to affect most of the skin. Scaling may appear in 2-6 days and be accompanied by hot, red, dry skin, malaise, and fever. Evidence: TAS. Frequency: Occasional (HP:0040283). (ORPHA:79481)
- Abnormal oral mucosa morphology (HP:0011830): Abnormality of the oral mucosa. Evidence: TAS. Frequency: Occasional (HP:0040283). (ORPHA:79481)
- Skin vesicle (HP:0200037): A circumscribed, fluid-containing, epidermal elevation less than 10mm in diameter at the widest point that (i) Contain serous exudates or serum mixed with blood or pus; (ii) Are discrete, grouped, irregularly distributed, or linear as in Rhus dermatitis; (iii) Are short-lived. Vesicles may break spontaneously or evolve into bullae by enlarging or coalescing with other vesicles. Evidence: TAS. Frequency: Occasional (HP:0040283). (ORPHA:79481)
- Psoriasiform dermatitis (HP:0003765): A skin abnormality characterized by redness and irritation, with thick, red skin that displays flaky, silver-white patches (scales). Evidence: TAS. Frequency: Very rare (HP:0040284). (ORPHA:79481)
- Hematological neoplasm (HP:0004377): Neoplasms located in the blood and blood-forming tissue (the bone marrow and lymphatic tissue). Evidence: TAS. Frequency: Very rare (HP:0040284). (ORPHA:79481)
- Neoplasm of the skin (HP:0008069): A tumor (abnormal growth of tissue) of the skin. Evidence: TAS. Frequency: Very rare (HP:0040284). (ORPHA:79481)
- Serpiginous cutaneous lesion (HP:0025527): A skin lesion with a snake- or serpent-like distribution. Evidence: TAS. Frequency: Very rare (HP:0040284). (ORPHA:79481)
- Annular cutaneous lesion (HP:0025528): A lesion of the skin with a ring-like distribution. Evidence: TAS. Frequency: Very rare (HP:0040284). (ORPHA:79481)
- Pustule (HP:0200039): A small elevation of the skin containing cloudy or purulent material usually consisting of necrotic inflammatory cells. Evidence: TAS. Frequency: Very rare (HP:0040284). (ORPHA:79481)
These phenotypes are associated with the disease Pemphigus foliaceus (ORPHA:79481).